- Neoplasm (HP:0002664): An organ or organ-system abnormality that consists of uncontrolled autonomous cell-proliferation which can occur in any part of the body as a benign or malignant neoplasm (tumor). Evidence: IEA. (OMIM:165660)
- Anemia (HP:0001903): A reduction in erythrocytes volume or hemoglobin concentration. Evidence: IEA. (OMIM:165660)
- Radial deviation of finger (HP:0009466): Bending or curvature of a finger toward the radial side (i.e., towards the thumb). The deviation is at the metacarpal-phalangeal joint, and this finding is distinct from clinodactyly. Evidence: IEA. (OMIM:165660)
- Osteosarcoma (HP:0002669): A malignant bone tumor that usually develops during adolescence and usually affects the long bones including the tibia, femur, and humerus. The typical symptoms of osteosarcoma comprise bone pain, fracture, limitation of motion, and tenderness or swelling at the site of the tumor. Evidence: TAS. (OMIM:165660)
- Clinodactyly (HP:0030084): An angulation of a digit at an interphalangeal joint in the plane of the palm (finger) or sole (toe). Evidence: TAS. (OMIM:165660)
- Autosomal dominant inheritance (HP:0000006): A mode of inheritance that is observed for traits related to a gene encoded on one of the autosomes (i.e., the human chromosomes 1-22) in which a trait manifests in heterozygotes. In the context of medical genetics, an autosomal dominant disorder is caused when a single copy of the mutant allele is present. Males and females are affected equally, and can both transmit the disorder with a risk of 50% for each child of inheriting the mutant allele. Evidence: IEA. (OMIM:165660)
- Radioulnar synostosis (HP:0002974): An abnormal osseous union (fusion) between the radius and the ulna. Evidence: IEA. (OMIM:165660)
These phenotypes are associated with the disease OSLAM syndrome (OMIM:165660).